- Microcephaly (HP:0000252): Head circumference below 2 standard deviations below the mean for age and gender. Evidence: TAS. (OMIM:614345)
- Delayed speech and language development (HP:0000750): A degree of language development that is significantly below the norm for a child of a specified age. Evidence: TAS. (OMIM:614345)
- Moderate intellectual disability (HP:0002342): Moderate intellectual disability (ID) is defined as a type of ID characterized by moderately sub-average adaptive functioning and intellectual functioning, with an intelligence quotient (IQ) the range of 35-49. Evidence: TAS. (OMIM:614345)
- Autosomal recessive inheritance (HP:0000007): A mode of inheritance that is observed for traits related to a gene encoded on one of the autosomes (i.e., the human chromosomes 1-22) in which a trait manifests in individuals with two pathogenic alleles, either homozygotes (two copies of the same mutant allele) or compound heterozygotes (whereby each copy of a gene has a distinct mutant allele). Evidence: TAS. (OMIM:614345)
- Motor delay (HP:0001270): A type of Developmental delay characterized by a delay in acquiring motor skills. Evidence: TAS. (OMIM:614345)
- Growth delay (HP:0001510): A deficiency or slowing down of growth pre- and postnatally. Evidence: TAS. (OMIM:614345)
These phenotypes are associated with the disease intellectual disability, autosomal recessive 24 (OMIM:614345).